- Abnormal sweat gland morphology (HP:0000971): Any structural abnormality of the sweat gland. Evidence: TAS. Frequency: Very frequent (HP:0040281). (ORPHA:247257)
- Fever (HP:0001945): Body temperature elevated above the normal range. Evidence: TAS. Frequency: Very frequent (HP:0040281). (ORPHA:247257)
- Focal autonomic seizure with epigastric sensation/nausea/vomiting/other gastrointestinal phenomena (HP:0011159): A type of focal autonomic seizure characterized by symptoms or signs pertaining to the gastrointestinal system as the initial semiological feature. Evidence: TAS. Frequency: Very frequent (HP:0040281). (ORPHA:247257)
- Fatigue (HP:0012378): A subjective feeling of tiredness characterized by a lack of energy and motivation. Evidence: TAS. Frequency: Very frequent (HP:0040281). (ORPHA:247257)
- Confusion (HP:0001289): Lack of clarity and coherence of thought, perception, understanding, or action. Evidence: TAS. Frequency: Frequent (HP:0040282). (ORPHA:247257)
- Vomiting (HP:0002013): Forceful ejection of the contents of the stomach through the mouth by means of a series of involuntary spasmic contractions. Evidence: TAS. Frequency: Frequent (HP:0040282). (ORPHA:247257)
- Dyspnea (HP:0002094): Difficult or labored breathing. Dyspnea is a subjective feeling only the patient can rate, e.g., on a Borg scale. Evidence: TAS. Frequency: Frequent (HP:0040282). (ORPHA:247257)
- Respiratory distress (HP:0002098): Respiratory distress is objectively observable as the physical or emotional consequences from the experience of dyspnea. The physical presentation of respiratory distress is generally referred to as labored breathing, while the sensation of respiratory distress is called shortness of breath or dyspnea. Evidence: TAS. Frequency: Frequent (HP:0040282). (ORPHA:247257)
- Incomprehensible speech (HP:0002546). Evidence: TAS. Frequency: Frequent (HP:0040282). (ORPHA:247257)
- Hypotension (HP:0002615): Low Blood Pressure, vascular hypotension. Evidence: TAS. Frequency: Frequent (HP:0040282). (ORPHA:247257)
- Internal hemorrhage (HP:0011029): The presence of hemorrhage within the body. Evidence: TAS. Frequency: Frequent (HP:0040282). (ORPHA:247257)
- Sepsis (HP:0100806): Sepsis is defined as life-threatening organ dysfunction caused by a dysregulated host response to infection. Evidence: TAS. Frequency: Frequent (HP:0040282). (ORPHA:247257)
These phenotypes are associated with the disease Inhalational anthrax (ORPHA:247257).